- Spicular pigmentation of the retina (HP:0007737): Pigment migration into the retina in a bone-spicule configuration (resembling the nucleated cells within the lacuna of bone). Evidence: PCS. (PMID:11527955)
- Nyctalopia (HP:0000662): Inability to see well at night or in poor light. Evidence: PCS. Onset: Childhood onset (HP:0011463). (PMID:11527955)
- Visual impairment (HP:0000505): Visual impairment (or vision impairment) is vision loss (of a person) to such a degree as to qualify as an additional support need through a significant limitation of visual capability resulting from either disease, trauma, or congenital or degenerative conditions that cannot be corrected by conventional means, such as refractive correction, medication, or surgery. Evidence: PCS. (PMID:11527955)
- Optic atrophy (HP:0000648): Atrophy of the optic nerve. Optic atrophy results from the death of the retinal ganglion cell axons that comprise the optic nerve and manifesting as a pale optic nerve on fundoscopy. Evidence: PCS. (PMID:11527955)
- Rod-cone dystrophy (HP:0000510): An inherited retinal disease subtype in which the rod photoreceptors appear to be more severely affected than the cone photoreceptors. Typical presentation is with nyctalopia (due to rod dysfunction) followed by loss of mid-peripheral field of vision, which gradually extends and leaves many patients with a small central island of vision due to the preservation of macular cones. Evidence: PCS. (PMID:11527955)
- Attenuation of retinal blood vessels (HP:0007843): Narrowing of the retinal blood vessels, both arterioles and venules. Evidence: PCS. (PMID:11527955)
- Autosomal dominant inheritance (HP:0000006): A mode of inheritance that is observed for traits related to a gene encoded on one of the autosomes (i.e., the human chromosomes 1-22) in which a trait manifests in heterozygotes. In the context of medical genetics, an autosomal dominant disorder is caused when a single copy of the mutant allele is present. Males and females are affected equally, and can both transmit the disorder with a risk of 50% for each child of inheriting the mutant allele. Evidence: PCS. (PMID:11527955)
- Chorioretinal atrophy (HP:0000533): Atrophy (wasting) of the choroid and retinal layers of the fundus. Evidence: PCS. (PMID:11527955)
These phenotypes are associated with the disease retinitis pigmentosa 30 (OMIM:607921).